- Posteriorly rotated ears (HP:0000358): A type of abnormal location of the ears in which the position of the ears is characterized by posterior rotation (the superior part of the ears is rotated towards the back of the head, and the inferior part of the ears towards the front). Evidence: TAS. Frequency: Frequent (HP:0040282). (ORPHA:2471)
- Prominent supraorbital ridges (HP:0000336): Greater than average forward and/or lateral protrusion of the supraorbital portion of the frontal bones. Evidence: TAS. Frequency: Very frequent (HP:0040281). (ORPHA:2471)
- Macrotia (HP:0000400): Median longitudinal ear length greater than two standard deviations above the mean and median ear width greater than two standard deviations above the mean (objective); or, apparent increase in length and width of the pinna (subjective). Evidence: TAS. Frequency: Very frequent (HP:0040281). (ORPHA:2471)
- Protruding ear (HP:0000411): Angle formed by the plane of the ear and the mastoid bone greater than the 97th centile for age (objective); or, outer edge of the helix more than 2 cm from the mastoid at the point of maximum distance (objective). Evidence: TAS. Frequency: Very frequent (HP:0040281). (ORPHA:2471)
- Prominent nose (HP:0000448): Distance between subnasale and pronasale more than two standard deviations above the mean, or alternatively, an apparently increased anterior protrusion of the nasal tip. Evidence: TAS. Frequency: Very frequent (HP:0040281). (ORPHA:2471)
- Strabismus (HP:0000486): A misalignment of the eyes so that the visual axes deviate from bifoveal fixation. The classification of strabismus may be based on a number of features including the relative position of the eyes, whether the deviation is latent or manifest, intermittent or constant, concomitant or otherwise and according to the age of onset and the relevance of any associated refractive error. Evidence: TAS. Frequency: Very frequent (HP:0040281). (ORPHA:2471)
- Synophrys (HP:0000664): Meeting of the medial eyebrows in the midline. Evidence: TAS. Frequency: Very frequent (HP:0040281). (ORPHA:2471)
- Intellectual disability (HP:0001249): The term intellectual disability or intellectual developmental disorder is used to describe significantly sub-average intellectual and adaptive functioning based on clinical assessment and as measured by individually administered, appropriately normed, standardized and validated tests of intellectual functioning and adaptive behavior, with onset during the developmental period from infancy through adolescence. Evidence: TAS. Frequency: Very frequent (HP:0040281). (ORPHA:2471)
- Scoliosis (HP:0002650): The presence of an abnormal lateral curvature of the spine. Evidence: TAS. Frequency: Very frequent (HP:0040281). (ORPHA:2471)
- Kyphosis (HP:0002808): Exaggerated anterior convexity of the thoracic vertebral column. Evidence: TAS. Frequency: Very frequent (HP:0040281). (ORPHA:2471)
- Short stature (HP:0004322): A height below that which is expected according to age and gender norms. Although there is no universally accepted definition of short stature, many refer to "short stature" as height more than 2 standard deviations below the mean for age and gender (or below the 3rd percentile for age and gender dependent norms). Evidence: TAS. Frequency: Very frequent (HP:0040281). (ORPHA:2471)
- Aplasia/Hypoplasia of the abdominal wall musculature (HP:0010318): Absence or underdevelopment of the abdominal musculature. Evidence: TAS. Frequency: Very frequent (HP:0040281). (ORPHA:2471)
- Open bite (HP:0010807): Visible space between the dental arches in occlusion. Evidence: TAS. Frequency: Very frequent (HP:0040281). (ORPHA:2471)
- Abnormal cardiovascular system morphology (HP:0030680): Any structural anomaly of the heart and blood vessels. Evidence: TAS. Frequency: Very frequent (HP:0040281). (ORPHA:2471)
- Cryptorchidism (HP:0000028): Testis in inguinal canal. That is, absence of one or both testes from the scrotum owing to failure of the testis or testes to descend through the inguinal canal to the scrotum. Evidence: TAS. Frequency: Frequent (HP:0040282). (ORPHA:2471)
- Abnormal palate morphology (HP:0000174): Any abnormality of the palate, i.e., of roof of the mouth. Evidence: TAS. Frequency: Frequent (HP:0040282). (ORPHA:2471)
- Mandibular prognathia (HP:0000303): Abnormal prominence of the chin related to increased length of the mandible. Evidence: TAS. Frequency: Frequent (HP:0040282). (ORPHA:2471)
- Hypertelorism (HP:0000316): Interpupillary distance more than 2 SD above the mean (alternatively, the appearance of an increased interpupillary distance or widely spaced eyes). Evidence: TAS. Frequency: Frequent (HP:0040282). (ORPHA:2471)
- Short philtrum (HP:0000322): Distance between nasal base and midline upper lip vermilion border more than 2 SD below the mean. Alternatively, an apparently decreased distance between nasal base and midline upper lip vermilion border. Evidence: TAS. Frequency: Frequent (HP:0040282). (ORPHA:2471)
- Micrognathia (HP:0000347): Developmental hypoplasia of the mandible. Evidence: TAS. Frequency: Frequent (HP:0040282). (ORPHA:2471)
- Underdeveloped nasal alae (HP:0000430): Thinned, deficient, or excessively arched ala nasi. Evidence: TAS. Frequency: Frequent (HP:0040282). (ORPHA:2471)
- Ptosis (HP:0000508): The upper eyelid margin is positioned 3 mm or more lower than usual and covers the superior portion of the iris (objective); or, the upper lid margin obscures at least part of the pupil (subjective). Evidence: TAS. Frequency: Frequent (HP:0040282). (ORPHA:2471)
- Dental malocclusion (HP:0000689): Dental malocclusion refers to an abnormality of the occlusion, or alignment, of the teeth and the way the upper and lower teeth fit together, resulting in overcrowding of teeth or in abnormal bite patterns. Evidence: TAS. Frequency: Frequent (HP:0040282). (ORPHA:2471)
- Pectus excavatum (HP:0000767): A defect of the chest wall characterized by a depression of the sternum, giving the chest ("pectus") a caved-in ("excavatum") appearance. Evidence: TAS. Frequency: Frequent (HP:0040282). (ORPHA:2471)
- Cachexia (HP:0004326): Severe weight loss, wasting of muscle, loss of appetite, and general debility related to a chronic disease. Evidence: TAS. Frequency: Frequent (HP:0040282). (ORPHA:2471)
- Bilateral single transverse palmar creases (HP:0007598): The distal and proximal transverse palmar creases are merged into a single transverse palmar crease on both hands. Evidence: TAS. Frequency: Frequent (HP:0040282). (ORPHA:2471)
- Short palpebral fissure (HP:0012745): Distance between the medial and lateral canthi is more than 2 SD below the mean for age (objective); or, apparently reduced length of the palpebral fissures. Evidence: TAS. Frequency: Frequent (HP:0040282). (ORPHA:2471)
These phenotypes are associated with the disease McDonough syndrome (ORPHA:2471).